Phenotypes associated with the disease myopia 1, X-linked (OMIM:310460, an entry in Online Mendelian Inheritance in Man):
- X-linked recessive inheritance (HP:0001419, a Human Phenotype Ontology term): A mode of inheritance that is observed for recessive traits related to a gene encoded on the X chromosome. In the context of medical genetics, X-linked recessive disorders manifest in males (who have one copy of the X chromosome and are thus hemizygotes), but generally not in female heterozygotes who have one mutant and one normal allele. Evidence: TAS. (OMIM:310460)
- X-linked inheritance (HP:0001417, a Human Phenotype Ontology term): A mode of inheritance that is observed for traits related to a gene encoded on the X chromosome. Evidence: IEA. (OMIM:310460)
- Myopia (HP:0000545, a Human Phenotype Ontology term): An abnormality of refraction characterized by the ability to see objects nearby clearly, while objects in the distance appear blurry. Evidence: IEA. (OMIM:310460)